- Thrombocytopenia (HP:0001873): A reduction in the number of circulating thrombocytes. Evidence: TAS. Frequency: Very frequent (HP:0040281). (ORPHA:91547)
- Fever (HP:0001945): Body temperature elevated above the normal range. Evidence: TAS. Frequency: Very frequent (HP:0040281). (ORPHA:91547)
- Increased total bilirubin (HP:0003573): Increased concentration of total (conjugated and unconjugated) bilirubin in the blood. Evidence: TAS. Frequency: Very frequent (HP:0040281). (ORPHA:91547)
- Elevated circulating C-reactive protein concentration (HP:0011227): The concentration of C-reactive protein in the blood circulation is above the upper limit of normal. Evidence: TAS. Frequency: Very frequent (HP:0040281). (ORPHA:91547)
- Jaundice (HP:0000952): Yellow pigmentation of the skin due to bilirubin, which in turn is the result of increased bilirubin concentration in the bloodstream. Evidence: TAS. Frequency: Frequent (HP:0040282). (ORPHA:91547)
- Anemia (HP:0001903): A reduction in erythrocytes volume or hemoglobin concentration. Evidence: TAS. Frequency: Frequent (HP:0040282). (ORPHA:91547)
- Increased total leukocyte count (HP:0001974): An abnormal increase in the number of leukocytes in the blood. Evidence: TAS. Frequency: Frequent (HP:0040282). (ORPHA:91547)
- Headache (HP:0002315): Cephalgia, or pain sensed in various parts of the head, not confined to the area of distribution of any nerve. Evidence: TAS. Frequency: Frequent (HP:0040282). (ORPHA:91547)
- Elevated circulating hepatic transaminase concentration (HP:0002910): Elevations of the levels of SGOT and SGPT in the serum. SGOT (serum glutamic oxaloacetic transaminase) and SGPT (serum glutamic pyruvic transaminase) are transaminases primarily found in the liver and heart and are released into the bloodstream as the result of liver or heart damage. SGOT and SGPT are used clinically mainly as markers of liver damage. Evidence: TAS. Frequency: Frequent (HP:0040282). (ORPHA:91547)
- Myalgia (HP:0003326): Pain in muscle. Evidence: TAS. Frequency: Frequent (HP:0040282). (ORPHA:91547)
- Increased circulating lactate dehydrogenase concentration (HP:0025435): An elevated level of the enzyme lactate dehydrogenase in the blood circulation. Evidence: TAS. Frequency: Frequent (HP:0040282). (ORPHA:91547)
- Abnormality of the urinary system (HP:0000079): An abnormality of the urinary system. Evidence: TAS. Frequency: Occasional (HP:0040283). (ORPHA:91547)
- Tachycardia (HP:0001649): A rapid heartrate that exceeds the range of the normal resting heartrate for age. Evidence: TAS. Frequency: Occasional (HP:0040283). (ORPHA:91547)
- Decreased total leukocyte count (HP:0001882): An abnormal decreased number of leukocytes in the blood. Evidence: TAS. Frequency: Occasional (HP:0040283). (ORPHA:91547)
- Abnormal bleeding (HP:0001892): An abnormal susceptibility to bleeding, often referred to as a bleeding diathesis. A bleeding diathesis may be related to vascular, platelet and coagulation defects. Evidence: TAS. Frequency: Occasional (HP:0040283). (ORPHA:91547)
- Acute kidney injury (HP:0001919): Sudden loss of renal function, as manifested by decreased urine production, and a rise in serum creatinine or blood urea nitrogen concentration (azotemia). Evidence: TAS. Frequency: Occasional (HP:0040283). (ORPHA:91547)
- Vomiting (HP:0002013): Forceful ejection of the contents of the stomach through the mouth by means of a series of involuntary spasmic contractions. Evidence: TAS. Frequency: Occasional (HP:0040283). (ORPHA:91547)
- Abdominal pain (HP:0002027): An unpleasant sensation characterized by physical discomfort (such as pricking, throbbing, or aching) and perceived to originate in the abdomen. Evidence: TAS. Frequency: Occasional (HP:0040283). (ORPHA:91547)
- Hypotension (HP:0002615): Low Blood Pressure, vascular hypotension. Evidence: TAS. Frequency: Occasional (HP:0040283). (ORPHA:91547)
- Arthralgia (HP:0002829): Joint pain. Evidence: TAS. Frequency: Occasional (HP:0040283). (ORPHA:91547)
- Elevated circulating creatinine concentration (HP:0003259): An increased amount of creatinine in the blood. Evidence: TAS. Frequency: Occasional (HP:0040283). (ORPHA:91547)
- Fatigue (HP:0012378): A subjective feeling of tiredness characterized by a lack of energy and motivation. Evidence: TAS. Frequency: Occasional (HP:0040283). (ORPHA:91547)
- Cough (HP:0012735): A sudden, audible expulsion of air from the lungs through a partially closed glottis, preceded by inhalation. Evidence: TAS. Frequency: Occasional (HP:0040283). (ORPHA:91547)
- Chills (HP:0025143): A sudden sensation of feeling cold. Evidence: TAS. Frequency: Occasional (HP:0040283). (ORPHA:91547)
- Nuchal rigidity (HP:0031179): Resistance of the extensor muscles of the neck to being bent forwards (i.e., impaired neck flexion) as a result of muscle spasm of the extensor muscles of the neck. Nuchal rigidity is not a fixed rigidity. Nuchal rigidity has been used as a bedside test for meningism, although its sensitivity for this purpose has been debated. Evidence: TAS. Frequency: Occasional (HP:0040283). (ORPHA:91547)
- Epistaxis (HP:0000421): Epistaxis, or nosebleed, refers to a hemorrhage localized in the nose. Evidence: TAS. Frequency: Very rare (HP:0040284). (ORPHA:91547)
- Hematuria (HP:0000790): The presence of blood in the urine. Hematuria may be gross hematuria (visible to the naked eye) or microscopic hematuria (detected by dipstick or microscopic examination of the urine). Evidence: TAS. Frequency: Very rare (HP:0040284). (ORPHA:91547)
- Diarrhea (HP:0002014): Abnormally increased frequency (usually defined as three or more) loose or watery bowel movements a day. Evidence: TAS. Frequency: Very rare (HP:0040284). (ORPHA:91547)
- Hemoptysis (HP:0002105): Coughing up (expectoration) of blood or blood-streaked sputum from the larynx, trachea, bronchi, or lungs. Evidence: TAS. Frequency: Very rare (HP:0040284). (ORPHA:91547)
- Prolonged prothrombin time (HP:0008151): Increased time to coagulation in the prothrombin time test, which is a measure of the extrinsic pathway of coagulation. The results of the prothrombin time test are often expressed in terms of the International normalized ratio (INR), which is calculated as a ratio of the patient's prothrombin time (PT) to a control PT standardized for the potency of the thromboplastin reagent developed by the World Health Organization (WHO) using the formula: INR is equal to Patient PT divided by Control PT. Evidence: TAS. Frequency: Very rare (HP:0040284). (ORPHA:91547)
- Increased total neutrophil count (HP:0011897): Abnormal increase of absolute number of neutrophils in the blood, per microliter, compared to a reference range for a given sex and age-group. Evidence: TAS. Frequency: Very rare (HP:0040284). (ORPHA:91547)
- Hyperfibrinogenemia (HP:0011899): Increased concentration of fibrinogen in the blood. Evidence: TAS. Frequency: Very rare (HP:0040284). (ORPHA:91547)
These phenotypes are associated with the disease Relapsing fever (ORPHA:91547).